- Joint swelling (HP:0001386, a Human Phenotype Ontology term). Evidence: TAS. Frequency: Very frequent (HP:0040281, a Human Phenotype Ontology term). (ORPHA:98878)
- Arthralgia (HP:0002829, a Human Phenotype Ontology term): Joint pain. Evidence: TAS. Frequency: Very frequent (HP:0040281, a Human Phenotype Ontology term). (ORPHA:98878)
- Reduced factor VIII activity (HP:0003125, a Human Phenotype Ontology term): Reduced activity of coagulation factor VIII. Factor VIII (fVIII) is a cofactor in the intrinsic clotting cascade that is activated to fVIIIa in the presence of minute quantities of thrombin. fVIIIa acts as a receptor, for factors IXa and X. Evidence: TAS. Frequency: Very frequent (HP:0040281, a Human Phenotype Ontology term). (ORPHA:98878)
- Joint hemorrhage (HP:0005261, a Human Phenotype Ontology term): Hemorrhage occurring within a joint. Evidence: TAS. Frequency: Occasional (HP:0040283, a Human Phenotype Ontology term). (ORPHA:98878)
- Bleeding with minor or no trauma (HP:0011889, a Human Phenotype Ontology term): Significant bleeding or hemorrhage without significant precipitating factor. Evidence: TAS. Frequency: Very frequent (HP:0040281, a Human Phenotype Ontology term). (ORPHA:98878)
- Thromboembolism (HP:0001907, a Human Phenotype Ontology term): The formation of a blood clot inside a blood vessel that subsequently travels through the blood stream from the site where it formed to another location in the body, generally leading to vascular occlusion at the distant site. Evidence: TAS. Frequency: Frequent (HP:0040282, a Human Phenotype Ontology term). (ORPHA:98878)
- Spontaneous hematomas (HP:0007420, a Human Phenotype Ontology term): Spontaneous development of hematomas (hematoma) or bruises without significant trauma. Evidence: TAS. Frequency: Frequent (HP:0040282, a Human Phenotype Ontology term). (ORPHA:98878)
- Oral cavity bleeding (HP:0030140, a Human Phenotype Ontology term): Recurrent or excessive bleeding from the mouth. Evidence: TAS. Frequency: Frequent (HP:0040282, a Human Phenotype Ontology term). (ORPHA:98878)
- Gastrointestinal hemorrhage (HP:0002239, a Human Phenotype Ontology term): Hemorrhage affecting the gastrointestinal tract. Evidence: TAS. Frequency: Occasional (HP:0040283, a Human Phenotype Ontology term). (ORPHA:98878)
- Abnormality of the elbow (HP:0009811, a Human Phenotype Ontology term): An anomaly of the joint that connects the upper and the lower arm. Evidence: TAS. Frequency: Occasional (HP:0040283, a Human Phenotype Ontology term). (ORPHA:98878)
- Intramuscular hematoma (HP:0012233, a Human Phenotype Ontology term): Blood clot formed within muscle tissue following leakage of blood into the tissue. Evidence: TAS. Frequency: Occasional (HP:0040283, a Human Phenotype Ontology term). (ORPHA:98878)
- Intraventricular hemorrhage (HP:0030746, a Human Phenotype Ontology term): Bleeding into the ventricles of the brain. Evidence: TAS. Frequency: Occasional (HP:0040283, a Human Phenotype Ontology term). (ORPHA:98878)
- Intracranial hemorrhage (HP:0002170, a Human Phenotype Ontology term): Hemorrhage occurring within the skull. Evidence: TAS. Frequency: Very rare (HP:0040284, a Human Phenotype Ontology term). (ORPHA:98878)
- Splenic rupture (HP:0012223, a Human Phenotype Ontology term): A breach of the capsule of the spleen. Evidence: TAS. Frequency: Very rare (HP:0040284, a Human Phenotype Ontology term). (ORPHA:98878)
These phenotypes are associated with the disease Hemophilia A (ORPHA:98878, an Orphanet rare-disease identifier).